- Lipoatrophy (HP:0100578): Localized loss of fat tissue. Evidence: TAS. Frequency: Obligate (HP:0040280). (ORPHA:90157)
- Reduced subcutaneous adipose tissue (HP:0003758): A reduced amount of fat tissue in the lowest layer of the integument. This feature can be appreciated by a reduced skinfold thickness. Evidence: TAS. Frequency: Very frequent (HP:0040281). (ORPHA:90157)
- Absence of subcutaneous fat (HP:0007485): Lack of subcutaneous adipose tissue. Evidence: TAS. Frequency: Frequent (HP:0040282). (ORPHA:90157)
- Hyperpigmentation of the skin (HP:0000953): A darkening of the skin related to an increase in melanin production and deposition. Evidence: TAS. Frequency: Occasional (HP:0040283). (ORPHA:90157)
- Hypopigmentation of the skin (HP:0001010): A reduction of skin color related to a decrease in melanin production and deposition. Evidence: TAS. Frequency: Occasional (HP:0040283). (ORPHA:90157)
- Erythema (HP:0010783): Redness of the skin, caused by hyperemia of the capillaries in the lower layers of the skin. Evidence: TAS. Frequency: Occasional (HP:0040283). (ORPHA:90157)
These phenotypes are associated with the disease Drug-induced localized lipodystrophy (ORPHA:90157).